Phenotypes associated with the disease angioedema, hereditary, 8 (OMIM:619367):
- Diarrhea (HP:0002014): Abnormally increased frequency (usually defined as three or more) loose or watery bowel movements a day. Evidence: PCS. (PMID:33508266)
- Angioedema (HP:0100665): Rapid swelling (edema) of the dermis, subcutaneous tissue, mucosa and submucosal tissues of the skin of the face, normally around the mouth, and the mucosa of the mouth and/or throat, as well as the tongue during a period of minutes to several hours. The swelling can also occur elsewhere, typically in the hands. Angioedema is similar to urticaria, but the swelling is subcutaneous rather than on the epidermis. Evidence: PCS. (PMID:33508266)
- Facial edema (HP:0000282). Evidence: PCS. (PMID:33508266)
- Episodic vomiting (HP:0002572): Paroxysmal, recurrent episodes of vomiting. Evidence: PCS. (PMID:33508266)
- Swollen lip (HP:0031244): Enlargement of the lip typically due to fluid buildup or inflammation. Evidence: PCS. (PMID:33508266)
- Laryngeal edema (HP:0012027): An abnormal accumulation of fluid and swelling in the tissues of the larynx. Evidence: PCS. (PMID:33508266)
- Autosomal dominant inheritance (HP:0000006): A mode of inheritance that is observed for traits related to a gene encoded on one of the autosomes (i.e., the human chromosomes 1-22) in which a trait manifests in heterozygotes. In the context of medical genetics, an autosomal dominant disorder is caused when a single copy of the mutant allele is present. Males and females are affected equally, and can both transmit the disorder with a risk of 50% for each child of inheriting the mutant allele. Evidence: PCS. (PMID:33508266)
- Edema of the dorsum of hands (HP:0007514): An abnormal accumulation of fluid beneath the skin on the back of the hands. Evidence: PCS. (PMID:33508266)
- Abdominal pain (HP:0002027): An unpleasant sensation characterized by physical discomfort (such as pricking, throbbing, or aching) and perceived to originate in the abdomen. Evidence: PCS. (PMID:33508266)